- Skin-picking (HP:0012166): Repetitive and compulsive picking of skin which results in tissue damage. Evidence: PCS. (PMID:15820710)
- Depression (HP:0000716): Frequently experiencing feelings of being down, miserable, and/or hopeless; struggling to recover from these moods; having a pessimistic outlook on the future; feeling a pervasive sense of shame; having a low self-worth; experiencing thoughts of suicide and engaging in suicidal behavior. Evidence: PCS. (PMID:15820710)
- Collectionism (HP:0030212): Excessive or pathological tendency to save and collect possessions. Evidence: PCS. (PMID:15820710)
- Anxiety (HP:0000739): Intense feelings of nervousness, tension, or panic often arise in response to interpersonal stresses. There is worry about the negative effects of past unpleasant experiences and future negative possibilities. Individuals may feel fearful, apprehensive, or threatened by uncertainty, and they may also have fears of falling apart or losing control. Evidence: PCS. (PMID:15820710)
- Compulsive behaviors (HP:0000722): Behavior that consists of repetitive acts, characterized by the feeling that one "has to" perform them, while being aware that these acts are not in line with one's overall goal. Evidence: IEA. (OMIM:164230)
- Autosomal dominant inheritance (HP:0000006): A mode of inheritance that is observed for traits related to a gene encoded on one of the autosomes (i.e., the human chromosomes 1-22) in which a trait manifests in heterozygotes. In the context of medical genetics, an autosomal dominant disorder is caused when a single copy of the mutant allele is present. Males and females are affected equally, and can both transmit the disorder with a risk of 50% for each child of inheriting the mutant allele. Evidence: TAS. (OMIM:164230)
These phenotypes are associated with the disease obsessive-compulsive disorder (OMIM:164230).